- Talipes equinovarus (HP:0001762): Talipes equinovarus (also called clubfoot) typically has four main components: inversion and adduction of the forefoot; inversion of the heel and hindfoot; equinus (limitation of extension) of the ankle and subtalar joint; and internal rotation of the leg. Evidence: TAS. Frequency: Occasional (HP:0040283). (OMIM:610017)
- Brachydactyly (HP:0001156): Digits that appear disproportionately short compared to the hand/foot. The word brachydactyly is used here to describe a series distinct patterns of shortened digits (brachydactyly types A-E). This is the sense used here. Evidence: TAS. (OMIM:610017)
- Vertebral fusion (HP:0002948): A developmental defect leading to the union of two adjacent vertebrae. Evidence: PCS. (PMID:16532400)
- Humeroradial synostosis (HP:0003041): An abnormal osseous union (fusion) between the radius and the humerus. Evidence: TAS. (OMIM:610017)
- Finger symphalangism (HP:0009700): An abnormal union between bones or parts of bones of the fingers. The synonymous term "symphalangism of the hand" may be translated as fusions of bones of varying digree, that involve at least one phalangeal bone of the hand. If bony fusions are referred to as "Symphalangism" the fusion occurs in a proximo-distal axis. Fusions of bones of the fingers in a radio-ulnar axis are referred to as "bony" Syndactyly. Evidence: PCS. (PMID:16532400)
- Tarsal synostosis (HP:0008368): Synostosis (bony fusion) involving one or more bones of the tarsus (calcaneus, talus, cuboid, navicular, cuneiiform bones). Evidence: PCS. (PMID:16532400)
- Carpal synostosis (HP:0009702): Synostosis (bony fusion) involving one or more bones of the carpus (scaphoid, lunate, triquetrum, trapezium, trapezoid, capitate, hamate, pisiform). Evidence: PCS. (PMID:16532400)
- Autosomal dominant inheritance (HP:0000006): A mode of inheritance that is observed for traits related to a gene encoded on one of the autosomes (i.e., the human chromosomes 1-22) in which a trait manifests in heterozygotes. In the context of medical genetics, an autosomal dominant disorder is caused when a single copy of the mutant allele is present. Males and females are affected equally, and can both transmit the disorder with a risk of 50% for each child of inheriting the mutant allele. Evidence: PCS. (PMID:16532400)
- Proximal symphalangism (HP:0100264). Evidence: TAS. (OMIM:610017)
- Wide nose (HP:0000445): Interalar distance more than two standard deviations above the mean for age, i.e., an apparently increased width of the nasal base and alae. Evidence: PCS. (PMID:16532400)
These phenotypes are associated with the disease multiple synostoses syndrome 2 (OMIM:610017).